- Micrognathia (HP:0000347): Developmental hypoplasia of the mandible. Evidence: TAS. Frequency: Very frequent (HP:0040281). (ORPHA:2050)
- Proptosis (HP:0000520): An eye that is protruding anterior to the plane of the face to a greater extent than is typical. Evidence: TAS. Frequency: Very frequent (HP:0040281). (ORPHA:2050)
- Blue sclerae (HP:0000592): An abnormal bluish coloration of the sclera. Evidence: TAS. Frequency: Very frequent (HP:0040281). (ORPHA:2050)
- Delayed eruption of teeth (HP:0000684): Delayed tooth eruption, which can be defined as tooth eruption more than 2 SD beyond the mean eruption age. Evidence: TAS. Frequency: Very frequent (HP:0040281). (ORPHA:2050)
- Abnormal rib morphology (HP:0000772): An anomaly of the rib. Evidence: TAS. Frequency: Very frequent (HP:0040281). (ORPHA:2050)
- Abnormal metaphysis morphology (HP:0000944): An abnormality of one or more metaphysis, i.e., of the somewhat wider portion of a long bone that is adjacent to the epiphyseal growth plate and grows during childhood. Evidence: TAS. Frequency: Very frequent (HP:0040281). (ORPHA:2050)
- Abnormality of the voice (HP:0001608). Evidence: TAS. Frequency: Very frequent (HP:0040281). (ORPHA:2050)
- Frontal bossing (HP:0002007): Bilateral bulging of the lateral frontal bone prominences with relative sparing of the midline. Evidence: TAS. Frequency: Very frequent (HP:0040281). (ORPHA:2050)
- Skeletal dysplasia (HP:0002652): A general term describing features characterized by abnormal development of bones and connective tissues. Evidence: TAS. Frequency: Very frequent (HP:0040281). (ORPHA:2050)
- Abnormal vertebral body morphology (HP:0003312): Abnormal form of vertebral body, which is the central cylindrical portion of the vertebra that together with other structures such as the vertebral arch, pedicles, laminae, spinous process, transverse processes, and articular facets makes up a vertebra. Evidence: TAS. Frequency: Very frequent (HP:0040281). (ORPHA:2050)
- Short stature (HP:0004322): A height below that which is expected according to age and gender norms. Although there is no universally accepted definition of short stature, many refer to "short stature" as height more than 2 standard deviations below the mean for age and gender (or below the 3rd percentile for age and gender dependent norms). Evidence: TAS. Frequency: Very frequent (HP:0040281). (ORPHA:2050)
- Crumpled long bones (HP:0006367): An crumpled radiographic appearance of the long bones, as if the long bone had been crushed together producing irregularities. This feature is the result of multiple fractures and repeated rounds of ineffective healing, as can be seen for instance in severe forms of osteogenesis imperfecta. Evidence: TAS. Frequency: Very frequent (HP:0040281). (ORPHA:2050)
- Bowing of the long bones (HP:0006487): A bending or abnormal curvature of a long bone. Evidence: TAS. Frequency: Very frequent (HP:0040281). (ORPHA:2050)
- Midface retrusion (HP:0011800): Posterior positions and/or vertical shortening of the infraorbital and perialar regions, or increased concavity of the face and/or reduced nasolabial angle. Evidence: TAS. Frequency: Very frequent (HP:0040281). (ORPHA:2050)
- Turricephaly (HP:0000262): Tall head relative to width and length. Evidence: TAS. Frequency: Frequent (HP:0040282). (ORPHA:2050)
- Abnormal dental enamel morphology (HP:0000682): An abnormality of the dental enamel. Evidence: TAS. Frequency: Frequent (HP:0040282). (ORPHA:2050)
- Hypotonia (HP:0001252): Hypotonia is an abnormally low muscle tone (the amount of tension or resistance to movement in a muscle). Even when relaxed, muscles have a continuous and passive partial contraction which provides some resistance to passive stretching. Hypotonia thus manifests as diminished resistance to passive stretching. Hypotonia is not the same as muscle weakness, although the two conditions can co-exist. Evidence: TAS. Frequency: Frequent (HP:0040282). (ORPHA:2050)
- Communicating hydrocephalus (HP:0001334): A form of hydrocephalus in which there is no visible obstruction to the flow of the cerebrospinal fluid between the ventricles and subarachnoid space. Evidence: TAS. Frequency: Frequent (HP:0040282). (ORPHA:2050)
- Intrauterine growth retardation (HP:0001511): An abnormal restriction of fetal growth with fetal weight below the tenth percentile for gestational age. Evidence: TAS. Frequency: Frequent (HP:0040282). (ORPHA:2050)
- Wormian bones (HP:0002645): The presence of extra bones within a cranial suture. Wormian bones are irregular isolated bones which appear in addition to the usual centers of ossification of the cranium. Evidence: TAS. Frequency: Frequent (HP:0040282). (ORPHA:2050)
- Scoliosis (HP:0002650): The presence of an abnormal lateral curvature of the spine. Evidence: TAS. Frequency: Frequent (HP:0040282). (ORPHA:2050)
- Recurrent fractures (HP:0002757): The repeated occurrence of bone fractures (implying an abnormally increased tendency for fracture). Evidence: TAS. Frequency: Frequent (HP:0040282). (ORPHA:2050)
- Kyphosis (HP:0002808): Exaggerated anterior convexity of the thoracic vertebral column. Evidence: TAS. Frequency: Frequent (HP:0040282). (ORPHA:2050)
- Downslanted palpebral fissures (HP:0000494): The palpebral fissure inclination is more than two standard deviations below the mean. Evidence: TAS. Frequency: Occasional (HP:0040283). (ORPHA:2050)
- Global developmental delay (HP:0001263): A delay in the achievement of motor or mental milestones in the domains of development of a child, including motor skills, speech and language, cognitive skills, and social and emotional skills. This term should only be used to describe children younger than five years of age. Evidence: TAS. Frequency: Occasional (HP:0040283). (ORPHA:2050)
- Joint hypermobility (HP:0001382): The capability that a joint (or a group of joints) has to move, passively and/or actively, beyond normal limits along physiological axes. Evidence: TAS. Frequency: Occasional (HP:0040283). (ORPHA:2050)
These phenotypes are associated with the disease Cole-Carpenter syndrome (ORPHA:2050).